Phenotypes associated with the disease Ptosis-vocal cord paralysis syndrome (ORPHA:2997):
- Ptosis (HP:0000508): The upper eyelid margin is positioned 3 mm or more lower than usual and covers the superior portion of the iris (objective); or, the upper lid margin obscures at least part of the pupil (subjective). Evidence: TAS. Frequency: Very frequent (HP:0040281). (ORPHA:2997)
- Laryngomalacia (HP:0001601): Laryngomalacia is a congenital abnormality of the laryngeal cartilage in which the cartilage is floppy and prolapses over the larynx during inspiration. Evidence: TAS. Frequency: Very frequent (HP:0040281). (ORPHA:2997)
- Hypernasal speech (HP:0001611): A type of speech characterized by the presence of an abnormally increased nasal airflow during speech associated with structural abnormality of the nasal passages. Evidence: TAS. Frequency: Very frequent (HP:0040281). (ORPHA:2997)
- Hemiplegia (HP:0002301): Paralysis (complete loss of muscle function) in the arm, leg, and in some cases the face on one side of the body. Evidence: TAS. Frequency: Very frequent (HP:0040281). (ORPHA:2997)
- Premature birth (HP:0001622): The birth of a baby of less than 37 weeks of gestational age. Evidence: TAS. Frequency: Frequent (HP:0040282). (ORPHA:2997)
- Severe short stature (HP:0003510): A severe degree of short stature, more than -4 SD from the mean corrected for age and sex. Evidence: TAS. Frequency: Frequent (HP:0040282). (ORPHA:2997)